- Visual impairment (HP:0000505): Visual impairment (or vision impairment) is vision loss (of a person) to such a degree as to qualify as an additional support need through a significant limitation of visual capability resulting from either disease, trauma, or congenital or degenerative conditions that cannot be corrected by conventional means, such as refractive correction, medication, or surgery. Evidence: TAS. Frequency: Very frequent (HP:0040281). (ORPHA:1574)
- Abnormal electroretinogram (HP:0000512): Any abnormality of the electrical responses of various cell types in the retina as measured by electroretinography. Evidence: TAS. Frequency: Very frequent (HP:0040281). (ORPHA:1574)
- Myopia (HP:0000545): An abnormality of refraction characterized by the ability to see objects nearby clearly, while objects in the distance appear blurry. Evidence: TAS. Frequency: Very frequent (HP:0040281). (ORPHA:1574)
- Microphthalmia (HP:0000568): A developmental anomaly characterized by abnormal smallness of one or both eyes. Evidence: TAS. Frequency: Very frequent (HP:0040281). (ORPHA:1574)
- Nystagmus (HP:0000639): Rhythmic, involuntary oscillations of one or both eyes related to abnormality in fixation, conjugate gaze, or vestibular mechanisms. Evidence: TAS. Frequency: Occasional (HP:0040283). (ORPHA:1574)
- Optic atrophy (HP:0000648): Atrophy of the optic nerve. Optic atrophy results from the death of the retinal ganglion cell axons that comprise the optic nerve and manifesting as a pale optic nerve on fundoscopy. Evidence: TAS. Frequency: Very frequent (HP:0040281). (ORPHA:1574)
- Abnormal retinal pigmentation (HP:0007703): Any deviation from the normal pigmentation of the retina. Evidence: TAS. Frequency: Very frequent (HP:0040281). (ORPHA:1574)
These phenotypes are associated with the disease Retinal degeneration-nanophthalmos-glaucoma syndrome (ORPHA:1574).